Phenotypes associated with the disease cataract 43 (OMIM:616279):
- Posterior subcapsular cataract (HP:0007787): A type of cataract affecting the posterior pole of lens immediately adjacent to ('beneath') the Lens capsule. Evidence: PCS. Frequency: 9/9. Onset: Juvenile onset (HP:0003621). (PMID:24549050)
- Autosomal dominant inheritance (HP:0000006): A mode of inheritance that is observed for traits related to a gene encoded on one of the autosomes (i.e., the human chromosomes 1-22) in which a trait manifests in heterozygotes. In the context of medical genetics, an autosomal dominant disorder is caused when a single copy of the mutant allele is present. Males and females are affected equally, and can both transmit the disorder with a risk of 50% for each child of inheriting the mutant allele. Evidence: PCS. (PMID:24549050)